- Neoplasm of the liver (HP:0002896): A tumor (abnormal growth of tissue) of the liver. Evidence: TAS. Frequency: Obligate (HP:0040280). (ORPHA:90003)
- Abnormal liver sonography (HP:0031140): An abnormal appearance of the liver or any of its components on sonography (ultrasound). Evidence: TAS. Frequency: Obligate (HP:0040280). (ORPHA:90003)
- Fever (HP:0001945): Body temperature elevated above the normal range. Evidence: TAS. Frequency: Frequent (HP:0040282). (ORPHA:90003)
- Abdominal pain (HP:0002027): An unpleasant sensation characterized by physical discomfort (such as pricking, throbbing, or aching) and perceived to originate in the abdomen. Evidence: TAS. Frequency: Frequent (HP:0040282). (ORPHA:90003)
- Autoimmune antibody positivity (HP:0030057): The presence of an antibody in the blood circulation that is directed against the organism's own cells or tissues. Evidence: TAS. Frequency: Frequent (HP:0040282). (ORPHA:90003)
- Diabetes mellitus (HP:0000819): A group of abnormalities characterized by hyperglycemia and glucose intolerance. Evidence: TAS. Frequency: Occasional (HP:0040283). (ORPHA:90003)
- Biliary tract abnormality (HP:0001080): An abnormality of the biliary tree. Evidence: TAS. Frequency: Occasional (HP:0040283). (ORPHA:90003)
- Cirrhosis (HP:0001394): A chronic disorder of the liver in which liver tissue becomes scarred and is partially replaced by regenerative nodules and fibrotic tissue resulting in loss of liver function. Evidence: TAS. Frequency: Occasional (HP:0040283). (ORPHA:90003)
- Weight loss (HP:0001824): Reduction of total body weight. Evidence: TAS. Frequency: Occasional (HP:0040283). (ORPHA:90003)
- Vomiting (HP:0002013): Forceful ejection of the contents of the stomach through the mouth by means of a series of involuntary spasmic contractions. Evidence: TAS. Frequency: Occasional (HP:0040283). (ORPHA:90003)
- Nausea (HP:0002018): A sensation of unease in the stomach together with an urge to vomit. Evidence: TAS. Frequency: Occasional (HP:0040283). (ORPHA:90003)
- Abdominal distention (HP:0003270): Distention of the abdomen. Evidence: TAS. Frequency: Occasional (HP:0040283). (ORPHA:90003)
- Asthenia (HP:0025406): A state characterized by a feeling of weakness and loss of strength leading to a generalized weakness of the body. Evidence: TAS. Frequency: Occasional (HP:0040283). (ORPHA:90003)
- Increased hepatitis B virus antibody level (HP:0410369): An abnormally increased level of immunoglobulin against hepatitis B virus in the blood. Evidence: TAS. Frequency: Occasional (HP:0040283). (ORPHA:90003)
- Elevated circulating aspartate aminotransferase concentration (HP:0031956): The concentration of aspartate aminotransferase (AST) in the blood circulation is above the upper limit of normal. Evidence: TAS. Frequency: Very rare (HP:0040284). (ORPHA:90003)
- Elevated circulating alanine aminotransferase concentration (HP:0031964): An abnormally high concentration in the circulation of alanine aminotransferase (ALT). Evidence: TAS. Frequency: Very rare (HP:0040284). (ORPHA:90003)
These phenotypes are associated with the disease Inflammatory pseudotumor of the liver (ORPHA:90003).
The following phenotypes are NOT associated with this disease:
- Elevated circulating alpha-fetoprotein concentration (HP:0006254): The concentration of alpha-fetoprotein in the blood circulation is above the upper limit of normal. Evidence: TAS. (ORPHA:90003)